- Compulsive behaviors (HP:0000722): Behavior that consists of repetitive acts, characterized by the feeling that one "has to" perform them, while being aware that these acts are not in line with one's overall goal. Evidence: TAS. Frequency: Very frequent (HP:0040281). (ORPHA:397725)
- Dysarthria (HP:0001260): Dysarthric speech is a general description referring to a neurological speech disorder characterized by poor articulation. Depending on the involved neurological structures, dysarthria may be further classified as spastic, flaccid, ataxic, hyperkinetic and hypokinetic, or mixed. Evidence: TAS. Frequency: Very frequent (HP:0040281). (ORPHA:397725)
- Gait disturbance (HP:0001288): The term gait disturbance can refer to any disruption of the ability to walk. Evidence: TAS. Frequency: Very frequent (HP:0040281). (ORPHA:397725)
- Parkinsonism (HP:0001300): Characteristic neurologic anomaly resulting from degeneration of dopamine-generating cells in the substantia nigra, a region of the midbrain, characterized clinically by shaking, rigidity, slowness of movement and difficulty with walking and gait. Evidence: TAS. Frequency: Very frequent (HP:0040281). (ORPHA:397725)
- Spastic paraparesis (HP:0002313): Partial loss of the ability to move the lower limbs accompanied by spasticity of the lower limbs. Evidence: TAS. Frequency: Very frequent (HP:0040281). (ORPHA:397725)
- Abnormal caudate nucleus morphology (HP:0002339): Any structural abnormality of the caudate nucleus. Evidence: TAS. Frequency: Very frequent (HP:0040281). (ORPHA:397725)
- Abnormal globus pallidus morphology (HP:0002453): An abnormality of the globus pallidus. Evidence: TAS. Frequency: Very frequent (HP:0040281). (ORPHA:397725)
- Eye of the tiger anomaly of globus pallidus (HP:0002454): The presence, on T2-weighted magnetic resonance imaging, of markedly low signal intensity of the globus pallidus that surrounds a central region of high signal intensity in the anteromedial globus pallidus, producing an eye-of-the-tiger appearance. The sign is thought to represent iron accumulation in the globus pallidus. Evidence: TAS. Frequency: Very frequent (HP:0040281). (ORPHA:397725)
- Peripheral axonal neuropathy (HP:0003477): An abnormality characterized by disruption of the normal functioning of peripheral axons. Evidence: TAS. Frequency: Very frequent (HP:0040281). (ORPHA:397725)
- Abnormal thalamus morphology (HP:0010663): An abnormality of the thalamus. Evidence: TAS. Frequency: Very frequent (HP:0040281). (ORPHA:397725)
- Abnormal corpus striatum morphology (HP:0010994): Abnormality of the striatum, which is the largest nucleus of the basal ganglia, comprising the caudate, putamen and ventral striatum, including the nucleus accumbens. Evidence: TAS. Frequency: Very frequent (HP:0040281). (ORPHA:397725)
- Oromandibular dystonia (HP:0012048): A kind of focal dystonia characterized by forceful contractions of the face, jaw, and/or tongue causing difficulty in opening and closing the mouth and often affecting chewing and speech. Evidence: TAS. Frequency: Very frequent (HP:0040281). (ORPHA:397725)
- Cognitive impairment (HP:0100543): Abnormal cognition is characterized by deficits in thinking, reasoning, or remembering. Evidence: TAS. Frequency: Very frequent (HP:0040281). (ORPHA:397725)
These phenotypes are associated with the disease COASY protein-associated neurodegeneration (ORPHA:397725).